Phenotypes associated with the disease Tricho-dento-osseous syndrome (ORPHA:3352):
- Abnormal mastoid morphology (HP:0000264): An abnormality of the mastoid process, which is the conical prominence projecting from the undersurface of the mastoid portion of the temporal bone. Evidence: TAS. Frequency: Frequent (HP:0040282). (ORPHA:3352)
- Dolichocephaly (HP:0000268): An abnormality of skull shape characterized by a increased anterior-posterior diameter, i.e., an increased antero-posterior dimension of the skull. Cephalic index less than 76%. Alternatively, an apparently increased antero-posterior length of the head compared to width. Often due to premature closure of the sagittal suture. Evidence: TAS. Frequency: Frequent (HP:0040282). (ORPHA:3352)
- Taurodontia (HP:0000679): Increased volume of dental pulp of permanent molar characterized by a crown body-root ratio equal or larger than 1:1 or an elongated pulp chambers and apical displacement of the bifurcation or trifurcation of the roots. Evidence: TAS. Frequency: Frequent (HP:0040282). (ORPHA:3352)
- Widely spaced teeth (HP:0000687): Increased spaces (diastemata) between most of the teeth in the same dental arch. Evidence: TAS. Frequency: Frequent (HP:0040282). (ORPHA:3352)
- Microdontia (HP:0000691): Decreased size of the teeth, which can be defined as a mesiodistal tooth diameter (width) more than 2 SD below mean. Alternatively, an apparently decreased maximum width of tooth. Evidence: TAS. Frequency: Frequent (HP:0040282). (ORPHA:3352)
- Abnormal nail morphology (HP:0001597): Abnormal structure or appearance of the nail. Evidence: TAS. Frequency: Frequent (HP:0040282). (ORPHA:3352)
- Fragile nails (HP:0001808): Nails that easily break. Evidence: TAS. Frequency: Frequent (HP:0040282). (ORPHA:3352)
- Frontal bossing (HP:0002007): Bilateral bulging of the lateral frontal bone prominences with relative sparing of the midline. Evidence: TAS. Frequency: Frequent (HP:0040282). (ORPHA:3352)
- Enamel hypomineralization (HP:0006285): A decreased amount of enamel mineralization. Hypomineralized enamel has a brown discoloration and brittle aspect. Evidence: TAS. Frequency: Frequent (HP:0040282). (ORPHA:3352)
- Dental enamel pits (HP:0009722): The presence of small depressions in the dental enamel. Evidence: TAS. Frequency: Frequent (HP:0040282). (ORPHA:3352)
- Increased bone mineral density (HP:0011001): An abnormal increase of bone mineral density, that is, of the amount of matter per cubic centimeter of bones which is often referred to as osteosclerosis. Osteosclerosis can be detected on radiological examination as an increased whiteness (density) of affected bones. Evidence: TAS. Frequency: Frequent (HP:0040282). (ORPHA:3352)
- Abnormal hair quantity (HP:0011362): An abnormal amount of hair. Evidence: TAS. Frequency: Frequent (HP:0040282). (ORPHA:3352)
- Obliteration of the calvarial diploe (HP:0030312): Absence of the spongy bone structure (or tissue) of the internal part of the skull cap (i.e., of the calvarial diploe). Evidence: TAS. Frequency: Frequent (HP:0040282). (ORPHA:3352)
- Periapical tooth abscess (HP:0030758): A tooth abscess that occurs at the tip of the root (apex) of a tooth. Evidence: TAS. Frequency: Frequent (HP:0040282). (ORPHA:3352)
- Agenesis of incisor (HP:0006485): Agenesis of incisor. Evidence: TAS. Frequency: Occasional (HP:0040283). (ORPHA:3352)
- Finger clinodactyly (HP:0040019). Evidence: TAS. Frequency: Occasional (HP:0040283). (ORPHA:3352)